- Endocardial fibrosis (HP:0006685): The presence of excessive connective tissue in the endocardium. Evidence: TAS. Frequency: Obligate (HP:0040280). (ORPHA:75565)
- Restrictive cardiomyopathy (HP:0001723): Restrictive left ventricular physiology is characterized by a pattern of ventricular filling in which increased stiffness of the myocardium causes ventricular pressure to rise precipitously with only small increases in volume, defined as restrictive ventricular physiology in the presence of normal or reduced diastolic volumes (of one or both ventricles), normal or reduced systolic volumes, and normal ventricular wall thickness. Evidence: TAS. Frequency: Very frequent (HP:0040281). (ORPHA:75565)
- Dyspnea (HP:0002094): Difficult or labored breathing. Dyspnea is a subjective feeling only the patient can rate, e.g., on a Borg scale. Evidence: TAS. Frequency: Very frequent (HP:0040281). (ORPHA:75565)
- Abnormal EKG (HP:0003115): Abnormal rhythm of the heart. Evidence: TAS. Frequency: Very frequent (HP:0040281). (ORPHA:75565)
- Fatigue (HP:0012378): A subjective feeling of tiredness characterized by a lack of energy and motivation. Evidence: TAS. Frequency: Very frequent (HP:0040281). (ORPHA:75565)
- Ascites (HP:0001541): Accumulation of fluid in the peritoneal cavity (between the layers of the peritoneum that lines the abdomen). Evidence: TAS. Frequency: Frequent (HP:0040282). (ORPHA:75565)
- Cardiomegaly (HP:0001640): Increased size of the heart, clinically defined as an increased transverse diameter of the cardiac silhouette that is greater than or equal to 50% of the transverse diameter of the chest (increased cardiothoracic ratio) on a posterior-anterior projection of a chest radiograph or a computed tomography. Evidence: TAS. Frequency: Frequent (HP:0040282). (ORPHA:75565)
- Atrioventricular block (HP:0001678): Delayed or lack of conduction of atrial depolarizations through the atrioventricular node to the ventricles. Evidence: TAS. Frequency: Frequent (HP:0040282). (ORPHA:75565)
- Fever (HP:0001945): Body temperature elevated above the normal range. Evidence: TAS. Frequency: Frequent (HP:0040282). (ORPHA:75565)
- Hepatomegaly (HP:0002240): Abnormally increased size of the liver. Evidence: TAS. Frequency: Frequent (HP:0040282). (ORPHA:75565)
- Hypoalbuminemia (HP:0003073): The concentration of albumin in the blood circulation is below the lower limit of normal. Evidence: TAS. Frequency: Frequent (HP:0040282). (ORPHA:75565)
- Cachexia (HP:0004326): Severe weight loss, wasting of muscle, loss of appetite, and general debility related to a chronic disease. Evidence: TAS. Frequency: Frequent (HP:0040282). (ORPHA:75565)
- Malnutrition (HP:0004395): A deficiency in the intake of energy and nutrients. Evidence: TAS. Frequency: Frequent (HP:0040282). (ORPHA:75565)
- Prolonged QRS complex (HP:0006677): Increased time for the complex comprised of the Q wave, R wave, and S wave as measured by the electrocardiogram (EKG).. In adults, normal values are 0.06 - 0.10 sec. Evidence: TAS. Frequency: Frequent (HP:0040282). (ORPHA:75565)
- Arrhythmia (HP:0011675): Any cardiac rhythm other than the normal sinus rhythm. Such a rhythm may be either of sinus or ectopic origin and either regular or irregular. An arrhythmia may be due to a disturbance in impulse formation or conduction or both. Evidence: TAS. Frequency: Frequent (HP:0040282). (ORPHA:75565)
- Complete right bundle branch block (HP:0011712): A conduction block of the right branch of the bundle of His. This manifests as a prolongation of the QRS complex (greater than 0.12 s) with delayed activation of the right ventricle and terminal delay on the EKG. Evidence: TAS. Frequency: Frequent (HP:0040282). (ORPHA:75565)
- Left bundle branch block (HP:0011713): A conduction block of the left branch of the bundle of His. This manifests as a generalized disturbance of QRS morphology on EKG. Evidence: TAS. Frequency: Frequent (HP:0040282). (ORPHA:75565)
- Abnormal ST segment (HP:0012249): An electrocardiographic anomaly of the ST segment, which is the segment that connects the QRS complex and the T wave. The ST segment normally has a duration of 80 to 120 ms, is flat and at the same level (isoelectric) as the PR and TP segment. Evidence: TAS. Frequency: Frequent (HP:0040282). (ORPHA:75565)
- Peripheral edema (HP:0012398): An abnormal accumulation of interstitial fluid in the soft tissues of the limbs. Evidence: TAS. Frequency: Frequent (HP:0040282). (ORPHA:75565)
- Orthopnea (HP:0012764): A sensation of breathlessness in the recumbent position, relieved by sitting or standing. Evidence: TAS. Frequency: Frequent (HP:0040282). (ORPHA:75565)
- Decreased QRS voltage (HP:0025077): Reduced amplitude (height) of the QRS complex of the electrocardiogram (EKG), defined as amplitudes of all the QRS complexes in the limb leads are less than 5 mm or amplitudes of all the QRS complexes in the precordial leads less than 10 mm. Evidence: TAS. Frequency: Frequent (HP:0040282). (ORPHA:75565)
- Left ventricular diastolic dysfunction (HP:0025168): Abnormal function of the left ventricule during left ventricular relaxation and filling. Evidence: TAS. Frequency: Frequent (HP:0040282). (ORPHA:75565)
- Pulmonary venous hypertension (HP:0030950): An abnormal increase in pressure in the pulmonary veins, usually as a result of left atrial hypertension. Evidence: TAS. Frequency: Frequent (HP:0040282). (ORPHA:75565)
- Left atrial enlargement (HP:0031295): Increase in size of the left atrium. Evidence: TAS. Frequency: Frequent (HP:0040282). (ORPHA:75565)
- Systolic heart murmur (HP:0031664): A heart murmur limited to systole, i.e., between the first and second heart sounds S1 and S2. Evidence: TAS. Frequency: Frequent (HP:0040282). (ORPHA:75565)
- Quadruple gallop rhythm (HP:0033114): A type of gallop rhythm in which both the third and the fourth sounds are present. Evidence: TAS. Frequency: Frequent (HP:0040282). (ORPHA:75565)
- Proptosis (HP:0000520): An eye that is protruding anterior to the plane of the face to a greater extent than is typical. Evidence: TAS. Frequency: Occasional (HP:0040283). (ORPHA:75565)
- Mitral regurgitation (HP:0001653): An abnormality of the mitral valve characterized by insufficiency or incompetence of the mitral valve resulting in retrograde leaking of blood through the mitral valve upon ventricular contraction. Evidence: TAS. Frequency: Occasional (HP:0040283). (ORPHA:75565)
- Splenomegaly (HP:0001744): Abnormal increased size of the spleen. Evidence: TAS. Frequency: Occasional (HP:0040283). (ORPHA:75565)
- Increased total eosinophil count (HP:0001880): Increased count of eosinophils in the blood. Evidence: TAS. Frequency: Occasional (HP:0040283). (ORPHA:75565)
- Thromboembolism (HP:0001907): The formation of a blood clot inside a blood vessel that subsequently travels through the blood stream from the site where it formed to another location in the body, generally leading to vascular occlusion at the distant site. Evidence: TAS. Frequency: Occasional (HP:0040283). (ORPHA:75565)
- Atrial flutter (HP:0004749): A type of atrial arrhythmia characterized by atrial rates of between 240 and 400 beats per minute and some degree of atrioventricular node conduction block. Typically, the ventricular rate is half the atrial rate. In the EKG; atrial flutter waves are observed as sawtooth-like atrial activity. Pathophysiologically, atrial flutter is a form of atrial reentry in which there is a premature electrical impulse creates a self-propagating circuit. Evidence: TAS. Frequency: Occasional (HP:0040283). (ORPHA:75565)
- Supraventricular tachycardia (HP:0004755): Supraventricular tachycardia (SVT) is an abnormally increased heart rate (over 100 beats per minute at rest) with origin above the level of the ventricles. Evidence: TAS. Frequency: Occasional (HP:0040283). (ORPHA:75565)
- Atrial fibrillation (HP:0005110): An atrial arrhythmia characterized by disorganized atrial activity without discrete P waves on the surface EKG, but instead by an undulating baseline or more sharply circumscribed atrial deflections of varying amplitude an frequency ranging from 350 to 600 per minute. Evidence: TAS. Frequency: Occasional (HP:0040283). (ORPHA:75565)
- Abnormal T-wave (HP:0005135): An abnormality of the T wave on the electrocardiogram, which mainly represents the repolarization of the ventricles. Evidence: TAS. Frequency: Occasional (HP:0040283). (ORPHA:75565)
- Tricuspid regurgitation (HP:0005180): Failure of the tricuspid valve to close sufficiently upon contraction of the right ventricle, causing blood to regurgitate (flow backward) into the right atrium. Evidence: TAS. Frequency: Occasional (HP:0040283). (ORPHA:75565)
- Myocardial calcification (HP:0006690): Calcium deposition in the myocardium. Evidence: TAS. Frequency: Occasional (HP:0040283). (ORPHA:75565)
- Pedal edema (HP:0010741): An abnormal accumulation of excess fluid in the lower extremity resulting in swelling of the feet and extending upward to the lower leg. Evidence: TAS. Frequency: Occasional (HP:0040283). (ORPHA:75565)
- Right ventricular cardiomyopathy (HP:0011663): Right ventricular dysfunction (global or regional) with functional and morphological right ventricular abnormalities, with or without left ventricular disease. Evidence: TAS. Frequency: Occasional (HP:0040283). (ORPHA:75565)
- Reduced left ventricular ejection fraction (HP:0012664): A diminution of the volumetric fraction of blood pumped out of the ventricle with each cardiac cycle. Evidence: TAS. Frequency: Occasional (HP:0040283). (ORPHA:75565)
- Autoimmune antibody positivity (HP:0030057): The presence of an antibody in the blood circulation that is directed against the organism's own cells or tissues. Evidence: TAS. Frequency: Occasional (HP:0040283). (ORPHA:75565)
- Cardiogenic shock (HP:0030149): Severely decreased cardiac output with evidence of inadequate end-organ perfusion (i.e., tissue hypoxia) in the presence of adequate intravascular volume. Evidence: TAS. Frequency: Occasional (HP:0040283). (ORPHA:75565)
- Increased circulating interleukin 6 concentration (HP:0030783): The concentration of interleukin-6 in the blood circulation is above the upper limit of normal. Evidence: TAS. Frequency: Occasional (HP:0040283). (ORPHA:75565)
- Elevated jugular venous pressure (HP:0030848): Increased jugular venous pressure. Evidence: TAS. Frequency: Occasional (HP:0040283). (ORPHA:75565)
- Abnormal P wave (HP:0031595): Any anomaly of the P wave of the EKG, which results from atrial depolarization. The P wave occurs when the sinoatrial node creates an action potential that depolarizes the atria. Evidence: TAS. Frequency: Occasional (HP:0040283). (ORPHA:75565)
- Abnormal atrioventricular valve physiology (HP:0031650): Any functional defect of the mitral or tricuspid valve. Evidence: TAS. Frequency: Occasional (HP:0040283). (ORPHA:75565)
- Coronary artery stenosis (HP:0005145): Abnormal narrowing of the coronary artery. Evidence: TAS. Frequency: Very rare (HP:0040284). (ORPHA:75565)
- P pulmonale (HP:0031601): The presence of tall, peaked P waves in EKG lead II. Evidence: TAS. Frequency: Very rare (HP:0040284). (ORPHA:75565)
These phenotypes are associated with the disease Tropical endomyocardial fibrosis (ORPHA:75565).